- Nystagmus (HP:0000639): Rhythmic, involuntary oscillations of one or both eyes related to abnormality in fixation, conjugate gaze, or vestibular mechanisms. Evidence: IEA. (OMIM:310800)
- X-linked dominant inheritance (HP:0001423): A mode of inheritance that is observed for dominant traits related to a gene encoded on the X chromosome. In the context of medical genetics, X-linked dominant disorders tend to manifest very severely in affected males. The severity of manifestation in females may depend on the degree of skewed X inactivation. Evidence: IEA. (OMIM:310800)
- Myoclonus (HP:0001336): Very brief, involuntary random muscular contractions occurring at rest, in response to sensory stimuli, or accompanying voluntary movements. Evidence: IEA. (OMIM:310800)
These phenotypes are associated with the disease nystagmus, myoclonic (OMIM:310800).